- Keratoconus (HP:0000563): A cone-shaped deformity of the cornea characterized by the presence of corneal distortion secondary to thinning of the apex. Evidence: TAS. (OMIM:614628)
- Autosomal dominant inheritance (HP:0000006): A mode of inheritance that is observed for traits related to a gene encoded on one of the autosomes (i.e., the human chromosomes 1-22) in which a trait manifests in heterozygotes. In the context of medical genetics, an autosomal dominant disorder is caused when a single copy of the mutant allele is present. Males and females are affected equally, and can both transmit the disorder with a risk of 50% for each child of inheriting the mutant allele. Evidence: TAS. (OMIM:614628)
These phenotypes are associated with the disease keratoconus 8 (OMIM:614628).